- Anti-phospholipase A2 receptor antibody positivity (HP:0034002): The presence of autoantibodies (immunoglobulins) in the blood circulation that react against the phospholipase A2 receptor. Evidence: TAS. Frequency: Frequent (HP:0040282). (ORPHA:97560)
This phenotype is associated with the disease Primary membranous glomerulonephritis (ORPHA:97560).